Phenotypes associated with the disease Brachydactyly type A2 (ORPHA:93396):
- Short foot (HP:0001773): A measured foot length that is more than 2 SD below the mean for a newborn of 27 - 41 weeks gestation, or foot that is less than the 3rd centile for individuals from birth to 16 years of age (objective). Alternatively, a foot that appears disproportionately short (subjective). Evidence: TAS. Frequency: Frequent (HP:0040282). (ORPHA:93396)
- Clinodactyly of the 5th finger (HP:0004209): Clinodactyly refers to a bending or curvature of the fifth finger in the radial direction (i.e., towards the 4th finger). Evidence: TAS. Frequency: Frequent (HP:0040282). (ORPHA:93396)
- Short middle phalanx of the 5th finger (HP:0004220): Hypoplastic/small middle phalanx of the fifth finger. Evidence: TAS. Frequency: Occasional (HP:0040283). (ORPHA:93396)
- Short middle phalanx of finger (HP:0005819): Short (hypoplastic) middle phalanx of finger, affecting one or more fingers. Evidence: TAS. Frequency: Occasional (HP:0040283). (ORPHA:93396)
- Type A2 brachydactyly (HP:0009372). Evidence: TAS. Frequency: Very frequent (HP:0040281). (ORPHA:93396)
- Aplasia/Hypoplasia of the middle phalanx of the 2nd finger (HP:0009568). Evidence: TAS. Frequency: Occasional (HP:0040283). (ORPHA:93396)
- Short 2nd metacarpal (HP:0010038): Short second metacarpal bone because of developmental hypoplasia. Evidence: TAS. Frequency: Occasional (HP:0040283). (ORPHA:93396)